- Abnormality of the immune system (HP:0002715): An abnormality of the immune system. Evidence: IEA. (OMIM:142395)
- Hepatitis (HP:0012115): Inflammation of the liver. Evidence: IEA. (OMIM:142395)
- Autosomal dominant inheritance (HP:0000006): A mode of inheritance that is observed for traits related to a gene encoded on one of the autosomes (i.e., the human chromosomes 1-22) in which a trait manifests in heterozygotes. In the context of medical genetics, an autosomal dominant disorder is caused when a single copy of the mutant allele is present. Males and females are affected equally, and can both transmit the disorder with a risk of 50% for each child of inheriting the mutant allele. Evidence: IEA. (OMIM:142395)
These phenotypes are associated with the disease HEPATITIS B VACCINE, RESPONSE TO (OMIM:142395).